- Abnormal bleeding (HP:0001892): An abnormal susceptibility to bleeding, often referred to as a bleeding diathesis. A bleeding diathesis may be related to vascular, platelet and coagulation defects. Evidence: PCS. Frequency: 2/2. (PMID:7727776)
- Congenital onset (HP:0003577): A phenotypic abnormality that is present at birth. Evidence: TAS. (OMIM:613225)
- Ecchymosis (HP:0031364): A purpuric lesion that is larger than 1 cm in diameter. Evidence: PCS. Frequency: 2/2. (PMID:7727776)
- Joint hemorrhage (HP:0005261): Hemorrhage occurring within a joint. Evidence: TAS. (OMIM:613225)
- Intracranial hemorrhage (HP:0002170): Hemorrhage occurring within the skull. Evidence: TAS. (OMIM:613225)
- Abnormal umbilical stump bleeding (HP:0011884): Abnormal bleeding of the umbilical stump following separation of the cord at approximately 7-10 days after birth. Evidence: PCS. Frequency: 2/2. (PMID:7727776)
- Factor XIII subunit A deficiency (HP:0040233): Deficiency of factor XIII subunit A, leading to a reduced factor XIII activity. Activated Factor XIII cross-links fibrin polymers solidifying the clot. Evidence: PCS. Frequency: 2/2. (PMID:7727776)
- Spontaneous hematomas (HP:0007420): Spontaneous development of hematomas (hematoma) or bruises without significant trauma. Evidence: PCS. Frequency: 1/2. (PMID:7727776)
- Autosomal recessive inheritance (HP:0000007): A mode of inheritance that is observed for traits related to a gene encoded on one of the autosomes (i.e., the human chromosomes 1-22) in which a trait manifests in individuals with two pathogenic alleles, either homozygotes (two copies of the same mutant allele) or compound heterozygotes (whereby each copy of a gene has a distinct mutant allele). Evidence: PCS. (PMID:7727776)
- Bruising susceptibility (HP:0000978): An ecchymosis (bruise) refers to the skin discoloration caused by the escape of blood into the tissues from ruptured blood vessels. This term refers to an abnormally increased susceptibility to bruising. The corresponding phenotypic abnormality is generally elicited on medical history as a report of frequent ecchymoses or bruising without adequate trauma. Evidence: PCS. Frequency: 2/2. (PMID:7727776)
- Reduced factor XIII activity (HP:0008357): Decreased activity of coagulation factor XIII (also known as fibrin stabilizing factor). Activated Factor XIII cross-links fibrin polymers solidifying the clot. Evidence: PCS. Frequency: 2/2. (PMID:7727776)
- Persistent bleeding after trauma (HP:0001934). Evidence: PCS. Frequency: 1/2. (PMID:7727776)
- Epistaxis (HP:0000421): Epistaxis, or nosebleed, refers to a hemorrhage localized in the nose. Evidence: TAS. (OMIM:613225)
- Neonatal onset (HP:0003623): Onset of signs or symptoms of disease within the first 28 days of life. Evidence: IEA. Frequency: 2/2. (PMID:7727776)
- Gingival bleeding (HP:0000225): Hemorrhage affecting the gingiva. Evidence: PCS. Frequency: 2/2. (PMID:7727776)
These phenotypes are associated with the disease factor XIII, A subunit, deficiency of (OMIM:613225).